- Abnormal glomerular basement membrane morphology (HP:0033282): Any abnormal sttructure of the glomerular basement membrane. Evidence: PCS. Frequency: 0/4. (PMID:11961012)
- Juvenile onset (HP:0003621): Onset of signs or symptoms of disease between the age of 5 and 15 years. Evidence: PCS. Frequency: 6/9. (PMID:11961012)
- Microscopic hematuria (HP:0002907): Microscopic hematuria detected by dipstick or microscopic examination of the urine. Evidence: PCS. Frequency: 9/9. (PMID:11961012)
- Sensorineural hearing impairment (HP:0000407): A type of hearing impairment in one or both ears related to an abnormal functionality of the cochlear nerve. Evidence: PCS. Frequency: 0/9. (PMID:11961012)
- Adult onset (HP:0003581): Onset of disease manifestations in adulthood, defined here as at the age of 16 years or later. Evidence: PCS. Frequency: 3/9. (PMID:11961012)
- Proteinuria (HP:0000093): Increased levels of protein in the urine. Evidence: PCS. Frequency: 0/9. (PMID:11961012)
- Autosomal dominant inheritance (HP:0000006): A mode of inheritance that is observed for traits related to a gene encoded on one of the autosomes (i.e., the human chromosomes 1-22) in which a trait manifests in heterozygotes. In the context of medical genetics, an autosomal dominant disorder is caused when a single copy of the mutant allele is present. Males and females are affected equally, and can both transmit the disorder with a risk of 50% for each child of inheriting the mutant allele. Evidence: PCS. (PMID:11961012)
These phenotypes are associated with the disease hematuria, benign familial, 2 (OMIM:620320).